- Typified by somatic mosaicism (HP:0001442): Description of conditions in which affected individuals typically display somatic mosaicism, i.e., genetically distinct populations of somatic cells in a given organism caused by DNA mutations, epigenetic alterations of DNA, chromosomal abnormalities or the spontaneous reversion of inherited mutations. In many conditions typified by somatic mosaicism, constitutive mutation is lethal and cases are exclusively or predominantly mosaic. Evidence: TAS. (OMIM:137245)
- Gastric lymphoma (HP:0045038): Lymphoma that originates in the stomach itself. Evidence: PCS. (PMID:8432445)
- Adult onset (HP:0003581): Onset of disease manifestations in adulthood, defined here as at the age of 16 years or later. Evidence: PCS. (PMID:8432445)
These phenotypes are associated with the disease MALT lymphoma (OMIM:137245).